Phenotypes associated with the disease cataract 32 multiple types (OMIM:115650):
- Anterior polar cataract (HP:0001134): A polar cataract that affects the anterior pole of the lens. Evidence: TAS. (OMIM:115650)
- Autosomal dominant inheritance (HP:0000006): A mode of inheritance that is observed for traits related to a gene encoded on one of the autosomes (i.e., the human chromosomes 1-22) in which a trait manifests in heterozygotes. In the context of medical genetics, an autosomal dominant disorder is caused when a single copy of the mutant allele is present. Males and females are affected equally, and can both transmit the disorder with a risk of 50% for each child of inheriting the mutant allele. Evidence: TAS. (OMIM:115650)